- Middle age onset (HP:0003596): A type of adult onset with onset of symptoms at the age of 40 to 60 years. Evidence: PCS. Frequency: 1/2. (PMID:21349352)
- ST segment elevation (HP:0012251): An electrocardiographic anomaly in which the ST segment is observed to be located superior to the isoelectric line. Evidence: PCS. Frequency: 2/2. (PMID:21349352)
- Young adult onset (HP:0011462): Onset of disease at the age of between 16 and 40 years. Evidence: PCS. Frequency: 1/2. (PMID:21349352)
- Prolonged QT interval (HP:0001657): Increased time between the start of the Q wave and the end of the T wave as measured by the electrocardiogram (EKG). Evidence: PCS. Frequency: 1/2. (PMID:21349352)
- Presyncope (HP:0031972): Presyncope is a state of lightheadedness, muscular weakness, blurred vision, and feeling faint. Presyncope is most often cardiovascular in cause. Evidence: PCS. Frequency: 1/2. (PMID:21349352)
- Palpitations (HP:0001962): A sensation that the heart is pounding or racing, which is a non-specific sign but may be a manifestation of arrhythmia. Evidence: PCS. Frequency: 2/2. (PMID:21349352)
- Autosomal dominant inheritance (HP:0000006): A mode of inheritance that is observed for traits related to a gene encoded on one of the autosomes (i.e., the human chromosomes 1-22) in which a trait manifests in heterozygotes. In the context of medical genetics, an autosomal dominant disorder is caused when a single copy of the mutant allele is present. Males and females are affected equally, and can both transmit the disorder with a risk of 50% for each child of inheriting the mutant allele. Evidence: PCS. (PMID:21349352)
These phenotypes are associated with the disease Brugada syndrome 9 (OMIM:616399).